Phenotypes associated with the disease chromosome 15q26-qter deletion syndrome (OMIM:612626):
- Micropenis (HP:0000054): Abnormally small penis. At birth, the normal penis is about 3 cm (stretched length from pubic tubercle to tip of penis) with micropenis less than 2.0-2.5 cm. Evidence: IEA. (OMIM:612626)
- Microcephaly (HP:0000252): Head circumference below 2 standard deviations below the mean for age and gender. Evidence: IEA. (OMIM:612626)
- Abnormal cardiac septum morphology (HP:0001671): An anomaly of the intra-atrial or intraventricular septum. Evidence: IEA. (OMIM:612626)
- Congenital onset (HP:0003577): A phenotypic abnormality that is present at birth. Evidence: IEA. (OMIM:612626)
- Wide nasal bridge (HP:0000431): Increased breadth of the nasal bridge (and with it, the nasal root). Evidence: IEA. (OMIM:612626)
- Strabismus (HP:0000486): A misalignment of the eyes so that the visual axes deviate from bifoveal fixation. The classification of strabismus may be based on a number of features including the relative position of the eyes, whether the deviation is latent or manifest, intermittent or constant, concomitant or otherwise and according to the age of onset and the relevance of any associated refractive error. Evidence: IEA. (OMIM:612626)
- Talipes equinovarus (HP:0001762): Talipes equinovarus (also called clubfoot) typically has four main components: inversion and adduction of the forefoot; inversion of the heel and hindfoot; equinus (limitation of extension) of the ankle and subtalar joint; and internal rotation of the leg. Evidence: IEA. (OMIM:612626)
- Short stature (HP:0004322): A height below that which is expected according to age and gender norms. Although there is no universally accepted definition of short stature, many refer to "short stature" as height more than 2 standard deviations below the mean for age and gender (or below the 3rd percentile for age and gender dependent norms). Evidence: IEA. (OMIM:612626)
- Brachydactyly (HP:0001156): Digits that appear disproportionately short compared to the hand/foot. The word brachydactyly is used here to describe a series distinct patterns of shortened digits (brachydactyly types A-E). This is the sense used here. Evidence: TAS. (OMIM:612626)
- Blepharophimosis (HP:0000581): A fixed reduction in the vertical distance between the upper and lower eyelids with short palpebral fissures. Evidence: IEA. (OMIM:612626)
- Global developmental delay (HP:0001263): A delay in the achievement of motor or mental milestones in the domains of development of a child, including motor skills, speech and language, cognitive skills, and social and emotional skills. This term should only be used to describe children younger than five years of age. Evidence: TAS. (OMIM:612626)
- Failure to thrive (HP:0001508): Failure to thrive (FTT) refers to a child whose physical growth is substantially below the norm. Evidence: IEA. (OMIM:612626)
- Small for gestational age (HP:0001518): Smaller than normal size according to sex and gestational age related norms, defined as a weight below the 10th percentile for the gestational age. Evidence: IEA. (OMIM:612626)
- Short middle phalanx of finger (HP:0005819): Short (hypoplastic) middle phalanx of finger, affecting one or more fingers. Evidence: IEA. (OMIM:612626)
- Sporadic (HP:0003745): Cases of the disease in question occur without a previous family history, i.e., as isolated cases without being transmitted from a parent and without other siblings being affected. Evidence: IEA. (OMIM:612626)
- Intrauterine growth retardation (HP:0001511): An abnormal restriction of fetal growth with fetal weight below the tenth percentile for gestational age. Evidence: IEA. (OMIM:612626)
- Hypospadias (HP:0000047): Abnormal position of urethral meatus on the ventral penile shaft (underside) characterized by displacement of the urethral meatus from the tip of the glans penis to the ventral surface of the penis, scrotum, or perineum. Evidence: IEA. (OMIM:612626)
- Cryptorchidism (HP:0000028): Testis in inguinal canal. That is, absence of one or both testes from the scrotum owing to failure of the testis or testes to descend through the inguinal canal to the scrotum. Evidence: IEA. (OMIM:612626)
- Triangular face (HP:0000325): Facial contour, as viewed from the front, triangular in shape, with breadth at the temples and tapering to a narrow chin. Evidence: IEA. (OMIM:612626)
- Micrognathia (HP:0000347): Developmental hypoplasia of the mandible. Evidence: IEA. (OMIM:612626)
- Low-set ears (HP:0000369): Upper insertion of the ear to the scalp below an imaginary horizontal line drawn between the inner canthi of the eye and extending posteriorly to the ear. Evidence: IEA. (OMIM:612626)
- Intellectual disability (HP:0001249): The term intellectual disability or intellectual developmental disorder is used to describe significantly sub-average intellectual and adaptive functioning based on clinical assessment and as measured by individually administered, appropriately normed, standardized and validated tests of intellectual functioning and adaptive behavior, with onset during the developmental period from infancy through adolescence. Evidence: IEA. (OMIM:612626)